- Abnormal circulating interleukin concentration (HP:0011117, a Human Phenotype Ontology term): The concentration of an interleukin (a class of cytokines) is outside the limits of normal. Evidence: TAS. Frequency: Frequent (HP:0040282, a Human Phenotype Ontology term). (ORPHA:85435)
- Arthritis (HP:0001369, a Human Phenotype Ontology term): Inflammation of a joint. Evidence: TAS. Frequency: Very frequent (HP:0040281, a Human Phenotype Ontology term). (ORPHA:85435)
- Arthralgia (HP:0002829, a Human Phenotype Ontology term): Joint pain. Evidence: TAS. Frequency: Very frequent (HP:0040281, a Human Phenotype Ontology term). (ORPHA:85435)
- Rheumatoid factor positive (HP:0002923, a Human Phenotype Ontology term): The presence in the serum of an autoantibody directed against the Fc portion of IgG. Evidence: TAS. Frequency: Very frequent (HP:0040281, a Human Phenotype Ontology term). (ORPHA:85435)
- Polyarticular arthritis (HP:0005764, a Human Phenotype Ontology term). Evidence: TAS. Frequency: Very frequent (HP:0040281, a Human Phenotype Ontology term). (ORPHA:85435)
- Limitation of joint mobility (HP:0001376, a Human Phenotype Ontology term): A reduction in the freedom of movement of one or more joints. Evidence: TAS. Frequency: Frequent (HP:0040282, a Human Phenotype Ontology term). (ORPHA:85435)
- Joint swelling (HP:0001386, a Human Phenotype Ontology term). Evidence: TAS. Frequency: Frequent (HP:0040282, a Human Phenotype Ontology term). (ORPHA:85435)
- Abnormal limb bone morphology (HP:0002813, a Human Phenotype Ontology term): Any abnormality of bones of the arms or legs. Evidence: TAS. Frequency: Frequent (HP:0040282, a Human Phenotype Ontology term). (ORPHA:85435)
- Elevated erythrocyte sedimentation rate (HP:0003565, a Human Phenotype Ontology term): An increased erythrocyte sedimentation rate (ESR). The ESR is a test that measures the distance that erythrocytes have fallen after one hour in a vertical column of anticoagulated blood under the influence of gravity. The ESR is a nonspecific finding. An elevation may indicate inflammation or may be caused by any condition that elevates fibrinogen. Evidence: TAS. Frequency: Frequent (HP:0040282, a Human Phenotype Ontology term). (ORPHA:85435)
- Progressive joint destruction (HP:0005187, a Human Phenotype Ontology term). Evidence: TAS. Frequency: Frequent (HP:0040282, a Human Phenotype Ontology term). (ORPHA:85435)
- Abnormal epiphysis morphology (HP:0005930, a Human Phenotype Ontology term): An anomaly of epiphysis, which is the expanded articular end of a long bone that developes from a secondary ossification center, and which during the period of growth is either entirely cartilaginous or is separated from the shaft by a cartilaginous disk. Evidence: TAS. Frequency: Frequent (HP:0040282, a Human Phenotype Ontology term). (ORPHA:85435)
- Interphalangeal joint erosions (HP:0006252, a Human Phenotype Ontology term). Evidence: TAS. Frequency: Frequent (HP:0040282, a Human Phenotype Ontology term). (ORPHA:85435)
- Elevated circulating C-reactive protein concentration (HP:0011227, a Human Phenotype Ontology term): The concentration of C-reactive protein in the blood circulation is above the upper limit of normal. Evidence: TAS. Frequency: Frequent (HP:0040282, a Human Phenotype Ontology term). (ORPHA:85435)
- Symmetric polyarthritis (HP:0040311, a Human Phenotype Ontology term): Polyarthritis refers to a joint disease that involves at least five joints. One or more signs of inflammation, including pain, movement restriction, swelling, warmth, and redness, are seen in the joints involved. Polyarthritis is defined as symmetric if at least half of the joints involved are affected in a symmetric (i.e., both right and the left) fashion. Evidence: TAS. Frequency: Frequent (HP:0040282, a Human Phenotype Ontology term). (ORPHA:85435)
- Synovitis (HP:0100769, a Human Phenotype Ontology term). Evidence: TAS. Frequency: Frequent (HP:0040282, a Human Phenotype Ontology term). (ORPHA:85435)
- Osteopenia (HP:0000938, a Human Phenotype Ontology term): Osteopenia is a term to define bone density that is not normal but also not as low as osteoporosis. By definition from the World Health Organization osteopenia is defined by bone densitometry as a T score -1 to -2.5. Evidence: TAS. Frequency: Occasional (HP:0040283, a Human Phenotype Ontology term). (ORPHA:85435)
- Reduced bone mineral density (HP:0004349, a Human Phenotype Ontology term): A reduction of bone mineral density, that is, of the amount of matter per cubic centimeter of bones. Evidence: TAS. Frequency: Occasional (HP:0040283, a Human Phenotype Ontology term). (ORPHA:85435)
- Premature epimetaphyseal fusion (HP:0010588, a Human Phenotype Ontology term): Stop of growth at the epiphyseal plate the hyaline cartilage plate in the metaphysis at each end of a long bone, at an earlier than normal age, resulting in growth arrest and shortening of the involved bone. Evidence: TAS. Frequency: Occasional (HP:0040283, a Human Phenotype Ontology term). (ORPHA:85435)
- Asymmetric growth (HP:0100555, a Human Phenotype Ontology term): A growth pattern that displays an abnormal difference between the left and the right side. Evidence: TAS. Frequency: Occasional (HP:0040283, a Human Phenotype Ontology term). (ORPHA:85435)
These phenotypes are associated with the disease Rheumatoid factor-positive polyarticular juvenile idiopathic arthritis (ORPHA:85435, an Orphanet rare-disease identifier).